Phenotypes associated with the disease osteoma of middle ear (OMIM:259650):
- Osteoma (HP:0100246): Osteomas are bony growths found most commonly on the skull and mandible; however, they may occur in any bone of the body. Osteomas do not usually cause clinical problems and do not become malignant. Evidence: IEA. (OMIM:259650)
- Autosomal recessive inheritance (HP:0000007): A mode of inheritance that is observed for traits related to a gene encoded on one of the autosomes (i.e., the human chromosomes 1-22) in which a trait manifests in individuals with two pathogenic alleles, either homozygotes (two copies of the same mutant allele) or compound heterozygotes (whereby each copy of a gene has a distinct mutant allele). Evidence: IEA. (OMIM:259650)
- Abnormality of the ear (HP:0000598): An abnormality of the ear. Evidence: IEA. (OMIM:259650)